Phenotypes associated with the disease autosomal dominant nonsyndromic hearing loss 7 (OMIM:601412):
- High-frequency hearing impairment (HP:0005101): A type of hearing impairment affecting primarily the higher frequencies of sound (3,000 to 6,000 Hz). Evidence: TAS. (OMIM:601412)
- Autosomal dominant inheritance (HP:0000006): A mode of inheritance that is observed for traits related to a gene encoded on one of the autosomes (i.e., the human chromosomes 1-22) in which a trait manifests in heterozygotes. In the context of medical genetics, an autosomal dominant disorder is caused when a single copy of the mutant allele is present. Males and females are affected equally, and can both transmit the disorder with a risk of 50% for each child of inheriting the mutant allele. Evidence: TAS. (OMIM:601412)